- Adult onset (HP:0003581): Onset of disease manifestations in adulthood, defined here as at the age of 16 years or later. Evidence: PCS. Frequency: 2/2. (PMID:7811989)
- Hypercoagulability (HP:0100724): An abnormality of coagulation associated with an increased risk of thrombosis. Evidence: PCS. (PMID:7811989)
- Deep venous thrombosis (HP:0002625): Formation of a blot clot in a deep vein. The clot often blocks blood flow, causing swelling and pain. The deep veins of the leg are most often affected. Evidence: PCS. Frequency: 1/2. (PMID:7811989)
- Autosomal dominant inheritance (HP:0000006): A mode of inheritance that is observed for traits related to a gene encoded on one of the autosomes (i.e., the human chromosomes 1-22) in which a trait manifests in heterozygotes. In the context of medical genetics, an autosomal dominant disorder is caused when a single copy of the mutant allele is present. Males and females are affected equally, and can both transmit the disorder with a risk of 50% for each child of inheriting the mutant allele. Evidence: PCS. (PMID:7811989)
- Pulmonary embolism (HP:0002204): An embolus (that is, an abnormal particle circulating in the blood) located in the pulmonary artery and thereby blocking blood circulation to the lung. Usually the embolus is a blood clot that has developed in an extremity (for instance, a deep venous thrombosis), detached, and traveled through the circulation before becoming trapped in the pulmonary artery. Evidence: PCS. Frequency: 1/2. (PMID:7811989)
These phenotypes are associated with the disease thrombomodulin-related bleeding disorder (OMIM:614486).